Phenotypes associated with the disease dyschromatosis symmetrica hereditaria (OMIM:127400):
- Infantile onset (HP:0003593): Onset of signs or symptoms of disease between 28 days to one year of life. Evidence: PCS. (PMID:12916015)
- Hyperpigmented/hypopigmented macules (HP:0007441). Evidence: PCS. (PMID:12916015)
- Autosomal dominant inheritance (HP:0000006): A mode of inheritance that is observed for traits related to a gene encoded on one of the autosomes (i.e., the human chromosomes 1-22) in which a trait manifests in heterozygotes. In the context of medical genetics, an autosomal dominant disorder is caused when a single copy of the mutant allele is present. Males and females are affected equally, and can both transmit the disorder with a risk of 50% for each child of inheriting the mutant allele. Evidence: PCS. (PMID:12916015)